- Multiple lipomas (HP:0001012): The presence of multiple lipomas (a type of benign tissue made of fatty tissue). Evidence: TAS. Frequency: Very frequent (HP:0040281). (ORPHA:199276)
- Subcutaneous lipoma (HP:0001031): The presence of subcutaneous lipoma. Evidence: TAS. Frequency: Very frequent (HP:0040281). (ORPHA:199276)
- Obesity (HP:0001513): Accumulation of substantial excess body fat. Evidence: TAS. Frequency: Occasional (HP:0040283). (ORPHA:199276)
- Cutaneous angiolipomas (HP:0006773). Evidence: TAS. Frequency: Occasional (HP:0040283). (ORPHA:199276)
- Peripheral neuropathy (HP:0009830): Peripheral neuropathy is a general term for any disorder of the peripheral nervous system. The main clinical features used to classify peripheral neuropathy are distribution, type (mainly demyelinating versus mainly axonal), duration, and course. Evidence: TAS. Frequency: Occasional (HP:0040283). (ORPHA:199276)
- Overweight (HP:0025502): Increased body weight with a body mass index of 25-29.9 kg per square meter. Evidence: TAS. Frequency: Occasional (HP:0040283). (ORPHA:199276)
- Painful subcutaneous lipomas (HP:0007596): The presence of multiple subcutaneous lipoma that cause pain. Evidence: TAS. Frequency: Very rare (HP:0040284). (ORPHA:199276)
- Subcutaneous calcification (HP:0007618): Deposition of calcium salts in subcutaneous tissue (i.e., the the lowermost layer of the integument). Evidence: TAS. Frequency: Very rare (HP:0040284). (ORPHA:199276)
These phenotypes are associated with the disease Familial multiple lipomatosis (ORPHA:199276).